- Atypical behavior (HP:0000708): Atypical behavior is an abnormality in a person's actions that can be controlled or modulated by the will of the individual. While abnormal behaviors can be difficult to control, they are distinct from other abnormal actions that cannot be affected by the individual's will. Evidence: TAS. Frequency: Very frequent (HP:0040281). (ORPHA:324723)
- Febrile seizure (within the age range of 3 months to 6 years) (HP:0002373): A febrile seizure is any type of seizure (most often a generalized tonic-clonic seizure) occurring with fever (at least 38 degrees Celsius) but in the absence of central nervous system infection, severe metabolic disturbance or other alternative precipitant in children between the ages of 3 months and 6 years. Evidence: TAS. Frequency: Very frequent (HP:0040281). (ORPHA:324723)
These phenotypes are associated with the disease ABeta amyloidosis, Arctic type (ORPHA:324723).